- Mild intellectual disability (HP:0001256): Mild intellectual disability (ID) is defined as a type of ID characterized by mildly sub-average adaptive functioning and intellectual functioning, with an intelligence quotient (IQ) the range of 50-69. Evidence: TAS. Frequency: Very frequent (HP:0040281). (ORPHA:254534)
- Global developmental delay (HP:0001263): A delay in the achievement of motor or mental milestones in the domains of development of a child, including motor skills, speech and language, cognitive skills, and social and emotional skills. This term should only be used to describe children younger than five years of age. Evidence: TAS. Frequency: Very frequent (HP:0040281). (ORPHA:254534)
- Polyhydramnios (HP:0001561): The presence of excess amniotic fluid in the uterus during pregnancy. Evidence: TAS. Frequency: Very frequent (HP:0040281). (ORPHA:254534)
- Thoracic hypoplasia (HP:0005257). Evidence: TAS. Frequency: Very frequent (HP:0040281). (ORPHA:254534)
- Large placenta (HP:0006267): Increased size of the placenta. Evidence: TAS. Frequency: Very frequent (HP:0040281). (ORPHA:254534)
- Coat hanger sign of ribs (HP:0006665): An abnormal morphology of the ribs consisting of shorted, abnormally curved ribs. On posteroanterior chest radiography, the ribs show a curvature resembling that of a coat hanger (clothes hanger). Evidence: TAS. Frequency: Very frequent (HP:0040281). (ORPHA:254534)
- Feeding difficulties in infancy (HP:0008872): Impaired feeding performance of an infant as manifested by difficulties such as weak and ineffective sucking, brief bursts of sucking, and falling asleep during sucking. There may be difficulties with chewing or maintaining attention. Evidence: TAS. Frequency: Very frequent (HP:0040281). (ORPHA:254534)
- Hypotonia (HP:0001252): Hypotonia is an abnormally low muscle tone (the amount of tension or resistance to movement in a muscle). Even when relaxed, muscles have a continuous and passive partial contraction which provides some resistance to passive stretching. Hypotonia thus manifests as diminished resistance to passive stretching. Hypotonia is not the same as muscle weakness, although the two conditions can co-exist. Evidence: TAS. Frequency: Frequent (HP:0040282). (ORPHA:254534)
- Large for gestational age (HP:0001520): The term large for gestational age applies to babies whose birth weight lies above the 90th percentile for that gestational age. Evidence: TAS. Frequency: Frequent (HP:0040282). (ORPHA:254534)
- Diastasis recti (HP:0001540): A separation of the rectus abdominis muscle into right and left halves (which are normally joined at the midline at the linea alba). Evidence: TAS. Frequency: Frequent (HP:0040282). (ORPHA:254534)
- Poor suck (HP:0002033): An inadequate sucking reflex, resulting in the difficult of newborns to be breast-fed. Evidence: TAS. Frequency: Frequent (HP:0040282). (ORPHA:254534)
- Postnatal growth retardation (HP:0008897): Slow or limited growth after birth. Evidence: TAS. Frequency: Frequent (HP:0040282). (ORPHA:254534)
- Small for gestational age (HP:0001518): Smaller than normal size according to sex and gestational age related norms, defined as a weight below the 10th percentile for the gestational age. Evidence: TAS. Frequency: Occasional (HP:0040283). (ORPHA:254534)
- Umbilical hernia (HP:0001537): Protrusion of abdominal contents through a defect in the abdominal wall musculature around the umbilicus. Skin and subcutaneous tissue overlie the defect. Evidence: TAS. Frequency: Occasional (HP:0040283). (ORPHA:254534)
- Omphalocele (HP:0001539): A midline anterior incomplete closure of the abdominal wall in which there is herniation of the abdominal viscera into the base of the abdominal cord. Evidence: TAS. Frequency: Occasional (HP:0040283). (ORPHA:254534)
- Overgrowth (HP:0001548): Excessive postnatal growth which may comprise increased weight, increased length, and/or increased head circumference. Evidence: TAS. Frequency: Occasional (HP:0040283). (ORPHA:254534)
- Abnormal heart morphology (HP:0001627): Any structural anomaly of the heart. Evidence: TAS. Frequency: Occasional (HP:0040283). (ORPHA:254534)
- Ventricular septal defect (HP:0001629): A hole between the two bottom chambers (ventricles) of the heart. The defect is centered around the most superior aspect of the ventricular septum. Evidence: TAS. Frequency: Occasional (HP:0040283). (ORPHA:254534)
- Delayed gross motor development (HP:0002194): A type of motor delay characterized by a delay in acquiring the ability to control the large muscles of the body for walking, running, sitting, and crawling. Evidence: TAS. Frequency: Occasional (HP:0040283). (ORPHA:254534)
These phenotypes are associated with the disease Kagami-Ogata syndrome due to maternal 14q32.2 hypermethylation (ORPHA:254534).